Phenotypes associated with the disease Circumscribed palmoplantar hypokeratosis (ORPHA:69744):
- Abnormality of the thenar eminence (HP:0001227): An abnormality of the thenar eminence, i.e., of the muscle on the palm of the human hand just beneath the thumb. Evidence: TAS. Frequency: Very frequent (HP:0040281). (ORPHA:69744)
- Abnormality of the hypothenar eminence (HP:0010486): An abnormality of the hypothenar eminence, i.e., of the muscles on the ulnar side of the palm of the hand (i.e., on the side of the little finger). Evidence: TAS. Frequency: Very frequent (HP:0040281). (ORPHA:69744)
- Abnormal skin morphology (HP:0011121): Any morphological abnormality of the skin. Evidence: TAS. Frequency: Very frequent (HP:0040281). (ORPHA:69744)
- Abnormality of the plantar skin of foot (HP:0100872): An abnormality of the plantar part of foot, that is of the soles of the feet. Evidence: TAS. Frequency: Very frequent (HP:0040281). (ORPHA:69744)
- Skin plaque (HP:0200035): A plaque is a solid, raised, plateau-like (flat-topped) lesion greater than 1 cm in diameter. Evidence: TAS. Frequency: Very frequent (HP:0040281). (ORPHA:69744)